- Intermittent jaundice (HP:0001046): Jaundice that is sometimes present, sometimes not. Evidence: PCS. (PMID:3090825)
- Hyperbilirubinemia (HP:0002904): An increased amount of bilirubin in the blood. Evidence: IEA. (OMIM:179700)
- Reticulocytosis (HP:0001923): An elevation in the number of reticulocytes (immature erythrocytes) in the peripheral blood circulation. Evidence: IEA. (OMIM:179700)
- Autosomal dominant inheritance (HP:0000006): A mode of inheritance that is observed for traits related to a gene encoded on one of the autosomes (i.e., the human chromosomes 1-22) in which a trait manifests in heterozygotes. In the context of medical genetics, an autosomal dominant disorder is caused when a single copy of the mutant allele is present. Males and females are affected equally, and can both transmit the disorder with a risk of 50% for each child of inheriting the mutant allele. Evidence: IEA. (OMIM:179700)
- Splenomegaly (HP:0001744): Abnormal increased size of the spleen. Evidence: PCS. (PMID:3090825)
These phenotypes are associated with the disease red cell phospholipid defect with hemolysis (OMIM:179700).